- Seizure (HP:0001250): A seizure is an intermittent abnormality of nervous system physiology characterized by a transient occurrence of signs and/or symptoms due to abnormal excessive or synchronous neuronal activity in the brain. Evidence: IEA. (OMIM:267740)
- Autosomal recessive inheritance (HP:0000007): A mode of inheritance that is observed for traits related to a gene encoded on one of the autosomes (i.e., the human chromosomes 1-22) in which a trait manifests in individuals with two pathogenic alleles, either homozygotes (two copies of the same mutant allele) or compound heterozygotes (whereby each copy of a gene has a distinct mutant allele). Evidence: IEA. (OMIM:267740)
- Retinal degeneration (HP:0000546): A nonspecific term denoting progressive loss of the retinal pigment epithelium (RPE) and/or neurosensory retinal cells. Evidence: IEA. (OMIM:267740)
These phenotypes are associated with the disease retinal degeneration and epilepsy (OMIM:267740).